Phenotypes associated with the disease PRUNE1-related neurological syndrome (ORPHA:544469):
- Bilateral talipes equinovarus (HP:0001776): Bilateral clubfoot deformity. Evidence: TAS. Frequency: Occasional (HP:0040283). (ORPHA:544469)
- Elevated circulating creatine kinase activity (HP:0003236): The activity of creatine kinase in the blood circulation is above the upper limit of normal. Evidence: TAS. Frequency: Occasional (HP:0040283). (ORPHA:544469)
- Epileptic spasm (HP:0011097): A sudden flexion, extension, or mixed extension-flexion of predominantly proximal and truncal muscles that is usually more sustained than a myoclonic movement but not as sustained as a tonic seizure. Limited forms may occur: Grimacing, head nodding, or subtle eye movements. Epileptic spasms frequently occur in clusters. Infantile spasms are the best known form, but spasms can occur at all ages. Evidence: TAS. Frequency: Occasional (HP:0040283). (ORPHA:544469)
- Cerebral visual impairment (HP:0100704): A form of loss of vision caused by damage to the visual cortex rather than a defect in the eye. Evidence: TAS. Frequency: Occasional (HP:0040283). (ORPHA:544469)
- Retinopathy (HP:0000488): Any noninflammatory disease of the retina. This nonspecific term is retained here because of its wide use in the literature, but if possible new annotations should indicate the precise type of retinal abnormality. Evidence: TAS. Frequency: Very rare (HP:0040284). (ORPHA:544469)
- Spastic paraparesis (HP:0002313): Partial loss of the ability to move the lower limbs accompanied by spasticity of the lower limbs. Evidence: TAS. Frequency: Very rare (HP:0040284). (ORPHA:544469)
- Global developmental delay (HP:0001263): A delay in the achievement of motor or mental milestones in the domains of development of a child, including motor skills, speech and language, cognitive skills, and social and emotional skills. This term should only be used to describe children younger than five years of age. Evidence: TAS. Frequency: Very frequent (HP:0040281). (ORPHA:544469)
- Spastic tetraparesis (HP:0001285): Spastic weakness affecting all four limbs. Evidence: TAS. Frequency: Very frequent (HP:0040281). (ORPHA:544469)
- Absent speech (HP:0001344): Complete lack of development of speech and language abilities. Evidence: TAS. Frequency: Very frequent (HP:0040281). (ORPHA:544469)
- Gastroesophageal reflux (HP:0002020): A condition in which the stomach contents leak backwards from the stomach into the esophagus through the lower esophageal sphincter. Evidence: TAS. Frequency: Very frequent (HP:0040281). (ORPHA:544469)
- Inability to walk (HP:0002540): Incapability to ambulate. Evidence: TAS. Frequency: Very frequent (HP:0040281). (ORPHA:544469)
- Axial hypotonia (HP:0008936): Muscular hypotonia (abnormally low muscle tone) affecting the musculature of the trunk. Evidence: TAS. Frequency: Very frequent (HP:0040281). (ORPHA:544469)
- Severe intellectual disability (HP:0010864): Severe intellectual disability (ID) is defined as a type of ID characterized by severely sub-average adaptive functioning and intellectual functioning, with an intelligence quotient (IQ) the range of 20-34. Evidence: TAS. Frequency: Very frequent (HP:0040281). (ORPHA:544469)
- Microcephaly (HP:0000252): Head circumference below 2 standard deviations below the mean for age and gender. Evidence: TAS. Frequency: Frequent (HP:0040282). (ORPHA:544469)
- Seizure (HP:0001250): A seizure is an intermittent abnormality of nervous system physiology characterized by a transient occurrence of signs and/or symptoms due to abnormal excessive or synchronous neuronal activity in the brain. Evidence: TAS. Frequency: Frequent (HP:0040282). (ORPHA:544469)
- Cerebellar atrophy (HP:0001272): Cerebellar atrophy is defined as a cerebellum with initially normal structures, in a posterior fossa with normal size, which displays enlarged fissures (interfolial spaces) in comparison to the foliae secondary to loss of tissue. Cerebellar atrophy implies irreversible loss of tissue and result from an ongoing progressive disease until a final stage is reached or a single injury, e.g. an intoxication or infectious event. Evidence: TAS. Frequency: Frequent (HP:0040282). (ORPHA:544469)
- Plagiocephaly (HP:0001357): Asymmetric head shape, which is usually a combination of unilateral occipital flattening with ipsilateral frontal prominence, leading to rhomboid cranial shape. Evidence: TAS. Frequency: Frequent (HP:0040282). (ORPHA:544469)
- Cerebral atrophy (HP:0002059): Atrophy (wasting, decrease in size of cells or tissue) affecting the cerebrum. Evidence: TAS. Frequency: Frequent (HP:0040282). (ORPHA:544469)
- Respiratory insufficiency (HP:0002093). Evidence: TAS. Frequency: Frequent (HP:0040282). (ORPHA:544469)
- Clonus (HP:0002169): A series of rhythmic and involuntary muscle contractions (at a frequency of about 5 to 7 Hz) that occur in response to an abruptly applied and sustained stretch. Evidence: TAS. Frequency: Frequent (HP:0040282). (ORPHA:544469)
- EEG abnormality (HP:0002353): Abnormality observed by electroencephalogram (EEG), which is used to record of the brain's spontaneous electrical activity from multiple electrodes placed on the scalp. Evidence: TAS. Frequency: Frequent (HP:0040282). (ORPHA:544469)
- Scoliosis (HP:0002650): The presence of an abnormal lateral curvature of the spine. Evidence: TAS. Frequency: Frequent (HP:0040282). (ORPHA:544469)
- Feeding difficulties in infancy (HP:0008872): Impaired feeding performance of an infant as manifested by difficulties such as weak and ineffective sucking, brief bursts of sucking, and falling asleep during sucking. There may be difficulties with chewing or maintaining attention. Evidence: TAS. Frequency: Frequent (HP:0040282). (ORPHA:544469)
- Delayed myelination (HP:0012448): Delayed myelination. Evidence: TAS. Frequency: Frequent (HP:0040282). (ORPHA:544469)
- Myoclonic seizure (HP:0032794): A myoclonic seizure is a type of motor seizure characterized by sudden, brief (<100 ms) involuntary single or multiple contraction of muscles or muscle groups of variable topography (axial, proximal limb, distal). Myoclonus is less regularly repetitive and less sustained than is clonus. Evidence: TAS. Frequency: Frequent (HP:0040282). (ORPHA:544469)
- Thin corpus callosum (HP:0033725): An abnormally thin corpus callous, due to atrophy, hypoplasia or agenesis. This term is intended to be used in situations where it is not known if thinning of the corpus callosum (for instance, as visualized by magnetic resonance tomography) is due to abnormal development (e.g. a leukodystrophy) or atrophy following normal development (e.g. neurodegeneration). Evidence: TAS. Frequency: Frequent (HP:0040282). (ORPHA:544469)
- Micrognathia (HP:0000347): Developmental hypoplasia of the mandible. Evidence: TAS. Frequency: Occasional (HP:0040283). (ORPHA:544469)
- Low-set ears (HP:0000369): Upper insertion of the ear to the scalp below an imaginary horizontal line drawn between the inner canthi of the eye and extending posteriorly to the ear. Evidence: TAS. Frequency: Occasional (HP:0040283). (ORPHA:544469)
- Cataract (HP:0000518): A cataract is an opacity or clouding that develops in the crystalline lens of the eye or in its capsule. Evidence: TAS. Frequency: Occasional (HP:0040283). (ORPHA:544469)
- Optic atrophy (HP:0000648): Atrophy of the optic nerve. Optic atrophy results from the death of the retinal ganglion cell axons that comprise the optic nerve and manifesting as a pale optic nerve on fundoscopy. Evidence: TAS. Frequency: Occasional (HP:0040283). (ORPHA:544469)
- Tongue fasciculations (HP:0001308): Fasciculations or fibrillation affecting the tongue muscle. Evidence: TAS. Frequency: Occasional (HP:0040283). (ORPHA:544469)
- Hyperreflexia (HP:0001347): Hyperreflexia is the presence of hyperactive stretch reflexes of the muscles. Evidence: TAS. Frequency: Occasional (HP:0040283). (ORPHA:544469)
- Hypertrophic cardiomyopathy (HP:0001639): Hypertrophic cardiomyopathy (HCM) is defined by the presence of increased ventricular wall thickness or mass in the absence of loading conditions (hypertension, valve disease) sufficient to cause the observed abnormality. Evidence: TAS. Frequency: Occasional (HP:0040283). (ORPHA:544469)